- Sensorineural hearing impairment (HP:0000407): A type of hearing impairment in one or both ears related to an abnormal functionality of the cochlear nerve. Evidence: TAS. Frequency: Occasional (HP:0040283). (OMIM:300436)
- X-linked recessive inheritance (HP:0001419): A mode of inheritance that is observed for recessive traits related to a gene encoded on the X chromosome. In the context of medical genetics, X-linked recessive disorders manifest in males (who have one copy of the X chromosome and are thus hemizygotes), but generally not in female heterozygotes who have one mutant and one normal allele. Evidence: TAS. (OMIM:300436)
- Intellectual disability (HP:0001249): The term intellectual disability or intellectual developmental disorder is used to describe significantly sub-average intellectual and adaptive functioning based on clinical assessment and as measured by individually administered, appropriately normed, standardized and validated tests of intellectual functioning and adaptive behavior, with onset during the developmental period from infancy through adolescence. Evidence: TAS. (OMIM:300436)
These phenotypes are associated with the disease intellectual disability, X-linked 46 (OMIM:300436).